- Insulin resistance (HP:0000855): Increased resistance towards insulin, that is, diminished effectiveness of insulin in reducing blood glucose levels. Evidence: TAS. Frequency: Obligate (HP:0040280). (ORPHA:79085)
- Lipodystrophy (HP:0009125): Degenerative changes of the fat tissue. Evidence: TAS. Frequency: Obligate (HP:0040280). (ORPHA:79085)
- Acanthosis nigricans (HP:0000956): A dermatosis characterized by thickened, hyperpigmented plaques, typically on the intertriginous surfaces and neck. Evidence: TAS. Frequency: Very frequent (HP:0040281). (ORPHA:79085)
- Hepatic steatosis (HP:0001397): Steatosis is a term used to denote lipid accumulation within hepatocytes. Evidence: TAS. Frequency: Very frequent (HP:0040281). (ORPHA:79085)
- Hypertriglyceridemia (HP:0002155): An abnormal increase in the level of triglycerides in the blood. Evidence: TAS. Frequency: Very frequent (HP:0040281). (ORPHA:79085)
- Hepatomegaly (HP:0002240): Abnormally increased size of the liver. Evidence: TAS. Frequency: Very frequent (HP:0040281). (ORPHA:79085)
- Decreased serum leptin (HP:0003292): A decreased concentration of leptin in the blood. Evidence: TAS. Frequency: Very frequent (HP:0040281). (ORPHA:79085)
- Increased intraabdominal fat (HP:0008993): An abnormal increase in the amount of intraabdominal fat tissue. Evidence: TAS. Frequency: Very frequent (HP:0040281). (ORPHA:79085)
- Decreased adiponectin level (HP:0030685): A reduced circulating concentration of adiponectin, a 30-kDa complement C1-related protein that is the most abundant secreted protein expressed in adipose tissue. Evidence: TAS. Frequency: Very frequent (HP:0040281). (ORPHA:79085)
- Polycystic ovaries (HP:0000147). Evidence: TAS. Frequency: Frequent (HP:0040282). (ORPHA:79085)
- Insulin-resistant diabetes mellitus (HP:0000831): A type of diabetes mellitus related not to lack of insulin but rather to lack of response to insulin on the part of the target tissues of insulin such as muscle, fat, and liver cells. This type of diabetes is typically associated with increases both in blood glucose concentrations as well as in fasting and postprandial serum insulin levels. Evidence: TAS. Frequency: Frequent (HP:0040282). (ORPHA:79085)
- Oligomenorrhea (HP:0000876): Infrequent menses (less than 6 per year or more than 35 days between cycles). Evidence: TAS. Frequency: Frequent (HP:0040282). (ORPHA:79085)
These phenotypes are associated with the disease AKT2-related familial partial lipodystrophy (ORPHA:79085).